Phenotypes associated with the disease Ptosis-upper ocular movement limitation-absence of lacrimal punctum syndrome (ORPHA:228396):
- Microretrognathia (HP:0000308): A form of developmental hypoplasia of the mandible in which the mandible is mislocalised posteriorly. Evidence: TAS. Frequency: Frequent (HP:0040282). (ORPHA:228396)
- Hypoplasia of the maxilla (HP:0000327): Abnormally small dimension of the Maxilla. Usually creating a malocclusion or malalignment between the upper and lower teeth or resulting in a deficient amount of projection of the base of the nose and lower midface region. Evidence: TAS. Frequency: Very frequent (HP:0040281). (ORPHA:228396)
- Sloping forehead (HP:0000340): Inclination of the anterior surface of the forehead from the vertical more than two standard deviations above the mean (objective); or apparently excessive posterior sloping of the forehead in a lateral view. Evidence: TAS. Frequency: Frequent (HP:0040282). (ORPHA:228396)
- Long philtrum (HP:0000343): Distance between nasal base and midline upper lip vermilion border more than 2 SD above the mean. Alternatively, an apparently increased distance between nasal base and midline upper lip vermilion border. Evidence: TAS. Frequency: Very frequent (HP:0040281). (ORPHA:228396)
- Posteriorly rotated ears (HP:0000358): A type of abnormal location of the ears in which the position of the ears is characterized by posterior rotation (the superior part of the ears is rotated towards the back of the head, and the inferior part of the ears towards the front). Evidence: TAS. Frequency: Frequent (HP:0040282). (ORPHA:228396)
- Abnormal pinna morphology (HP:0000377): An abnormality of the pinna, which is also referred to as the auricle or external ear. Evidence: TAS. Frequency: Frequent (HP:0040282). (ORPHA:228396)
- Anteverted nares (HP:0000463): Anteriorly-facing nostrils viewed with the head in the Frankfurt horizontal and the eyes of the observer level with the eyes of the subject. This gives the appearance of an upturned nose (upturned nasal tip). Evidence: TAS. Frequency: Very frequent (HP:0040281). (ORPHA:228396)
- Abnormality of eye movement (HP:0000496): An abnormality in voluntary or involuntary eye movements or their control. Evidence: TAS. Frequency: Very frequent (HP:0040281). (ORPHA:228396)
- Telecanthus (HP:0000506): Distance between the inner canthi more than two standard deviations above the mean (objective); or, apparently increased distance between the inner canthi. Evidence: TAS. Frequency: Very frequent (HP:0040281). (ORPHA:228396)
- Ptosis (HP:0000508): The upper eyelid margin is positioned 3 mm or more lower than usual and covers the superior portion of the iris (objective); or, the upper lid margin obscures at least part of the pupil (subjective). Evidence: TAS. Frequency: Very frequent (HP:0040281). (ORPHA:228396)
- Absent eyelashes (HP:0000561): Lack of eyelashes. Evidence: TAS. Frequency: Very frequent (HP:0040281). (ORPHA:228396)
- Thick eyebrow (HP:0000574): Increased density/number and/or increased diameter of eyebrow hairs. Evidence: TAS. Frequency: Very frequent (HP:0040281). (ORPHA:228396)
- Absent lacrimal punctum (HP:0001092): No identifiable superior and/or inferior lacrimal punctum. Evidence: TAS. Frequency: Very frequent (HP:0040281). (ORPHA:228396)
- Highly arched eyebrow (HP:0002553): Increased height of the central portion of the eyebrow, forming a crescent, semicircular, or inverted U shape. Evidence: TAS. Frequency: Very frequent (HP:0040281). (ORPHA:228396)
- Clinodactyly of the 5th finger (HP:0004209): Clinodactyly refers to a bending or curvature of the fifth finger in the radial direction (i.e., towards the 4th finger). Evidence: TAS. Frequency: Very frequent (HP:0040281). (ORPHA:228396)
- Biparietal narrowing (HP:0004422): A narrowing of the biparietal diameter (i.e., of the transverse distance between the protuberances of the two parietal bones of the skull). Evidence: TAS. Frequency: Very frequent (HP:0040281). (ORPHA:228396)
- Tricuspid regurgitation (HP:0005180): Failure of the tricuspid valve to close sufficiently upon contraction of the right ventricle, causing blood to regurgitate (flow backward) into the right atrium. Evidence: TAS. Frequency: Frequent (HP:0040282). (ORPHA:228396)
- Thick vermilion border (HP:0012471): Increased width of the skin of vermilion border region of upper lip. Evidence: TAS. Frequency: Frequent (HP:0040282). (ORPHA:228396)